- Congenital onset (HP:0003577): A phenotypic abnormality that is present at birth. Evidence: PCS. (PMID:26197441)
- Abnormal vestibular function (HP:0001751): An abnormality of the functioning of the vestibular apparatus. Evidence: IEA. Frequency: 0/11. (PMID:26197441)
- Sensorineural hearing impairment (HP:0000407): A type of hearing impairment in one or both ears related to an abnormal functionality of the cochlear nerve. Evidence: PCS. Frequency: 11/11. (PMID:26197441)
- Childhood onset (HP:0011463): Onset of disease at the age of between 1 and 5 years. Evidence: PCS. (PMID:26197441)
- Young adult onset (HP:0011462): Onset of disease at the age of between 16 and 40 years. Evidence: PCS. (PMID:26197441)
- Autosomal dominant inheritance (HP:0000006): A mode of inheritance that is observed for traits related to a gene encoded on one of the autosomes (i.e., the human chromosomes 1-22) in which a trait manifests in heterozygotes. In the context of medical genetics, an autosomal dominant disorder is caused when a single copy of the mutant allele is present. Males and females are affected equally, and can both transmit the disorder with a risk of 50% for each child of inheriting the mutant allele. Evidence: PCS. (PMID:26197441)
These phenotypes are associated with the disease autosomal dominant nonsyndromic hearing loss 66 (OMIM:616969).